- Hypospadias (HP:0000047): Abnormal position of urethral meatus on the ventral penile shaft (underside) characterized by displacement of the urethral meatus from the tip of the glans penis to the ventral surface of the penis, scrotum, or perineum. Evidence: TAS. Frequency: Frequent (HP:0040282). (ORPHA:1046)
- Abnormality of the ureter (HP:0000069): An abnormality of the ureter. The ureter is the duct by which urine passes from the kidney to the bladder. Evidence: TAS. Frequency: Very frequent (HP:0040281). (ORPHA:1046)
- Narrow mouth (HP:0000160): Distance between the commissures of the mouth more than 2 SD below the mean. Alternatively, an apparently decreased width of the oral aperture (subjective). Evidence: TAS. Frequency: Frequent (HP:0040282). (ORPHA:1046)
- Thin vermilion border (HP:0000233): Height of the vermilion of the medial part of the lip more than 2 SD below the mean, or apparently reduced height of the vermilion of the lip in the frontal view. The vermilion is the red part of the lips (and confusingly, the vermilion itself is also often referred to as being equivalent the lips). Evidence: TAS. Frequency: Frequent (HP:0040282). (ORPHA:1046)
- Microcephaly (HP:0000252): Head circumference below 2 standard deviations below the mean for age and gender. Evidence: TAS. Frequency: Frequent (HP:0040282). (ORPHA:1046)
- Micrognathia (HP:0000347): Developmental hypoplasia of the mandible. Evidence: TAS. Frequency: Frequent (HP:0040282). (ORPHA:1046)
- Depressed nasal ridge (HP:0000457): Lack of prominence of the nose resulting from a posteriorly-placed nasal ridge. Evidence: TAS. Frequency: Frequent (HP:0040282). (ORPHA:1046)
- Abnormal skull morphology (HP:0000929): An abnormality of the skull, the bony framework of the head which is comprised of the neurocranium (with eight cranial bones) and the viscerocranium (facial skeleton) that comprises fourteen facial bones with the mandible as its largest bone. Evidence: TAS. Frequency: Very frequent (HP:0040281). (ORPHA:1046)
- Hypotonia (HP:0001252): Hypotonia is an abnormally low muscle tone (the amount of tension or resistance to movement in a muscle). Even when relaxed, muscles have a continuous and passive partial contraction which provides some resistance to passive stretching. Hypotonia thus manifests as diminished resistance to passive stretching. Hypotonia is not the same as muscle weakness, although the two conditions can co-exist. Evidence: TAS. Frequency: Frequent (HP:0040282). (ORPHA:1046)
- Ascites (HP:0001541): Accumulation of fluid in the peritoneal cavity (between the layers of the peritoneum that lines the abdomen). Evidence: TAS. Frequency: Frequent (HP:0040282). (ORPHA:1046)
- Polyhydramnios (HP:0001561): The presence of excess amniotic fluid in the uterus during pregnancy. Evidence: TAS. Frequency: Frequent (HP:0040282). (ORPHA:1046)
- Oligohydramnios (HP:0001562): Diminished amniotic fluid volume in pregnancy. Evidence: TAS. Frequency: Very frequent (HP:0040281). (ORPHA:1046)
- Splenomegaly (HP:0001744): Abnormal increased size of the spleen. Evidence: TAS. Frequency: Frequent (HP:0040282). (ORPHA:1046)
- Sandal gap (HP:0001852): A widely spaced gap between the first toe (the great toe) and the second toe. Evidence: TAS. Frequency: Very frequent (HP:0040281). (ORPHA:1046)
- Anemia (HP:0001903): A reduction in erythrocytes volume or hemoglobin concentration. Evidence: TAS. Frequency: Very frequent (HP:0040281). (ORPHA:1046)
- Abnormality of coagulation (HP:0001928): An abnormality of the process of blood coagulation. That is, altered ability or inability of the blood to clot. Evidence: TAS. Frequency: Frequent (HP:0040282). (ORPHA:1046)
- Respiratory insufficiency (HP:0002093). Evidence: TAS. Frequency: Very frequent (HP:0040281). (ORPHA:1046)
- Aplasia/Hypoplasia of the lungs (HP:0006703). Evidence: TAS. Frequency: Frequent (HP:0040282). (ORPHA:1046)
- Renal hypoplasia/aplasia (HP:0008678): Absence or underdevelopment of the kidney. Evidence: TAS. Frequency: Frequent (HP:0040282). (ORPHA:1046)
- Hypoplasia of penis (HP:0008736). Evidence: TAS. Frequency: Very frequent (HP:0040281). (ORPHA:1046)
These phenotypes are associated with the disease Lethal hemolytic anemia-genital anomalies syndrome (ORPHA:1046).